- Distal finger symphalangism (HP:0001204): The term distal symphalangism refers to a bony fusion of the distal and middle phalanges of the digits of the hand, in other words the distal interphalangeal joint (DIJ) is missing which can be seen either on x-rays or as an absence of the distal interphalangeal finger creases. Evidence: TAS. Frequency: Occasional (HP:0040283). (ORPHA:93388)
- Broad metacarpals (HP:0001230): Abnormally broad metacarpal bones. Evidence: TAS. Frequency: Occasional (HP:0040283). (ORPHA:93388)
- Talipes equinovarus (HP:0001762): Talipes equinovarus (also called clubfoot) typically has four main components: inversion and adduction of the forefoot; inversion of the heel and hindfoot; equinus (limitation of extension) of the ankle and subtalar joint; and internal rotation of the leg. Evidence: TAS. Frequency: Occasional (HP:0040283). (ORPHA:93388)
- Short foot (HP:0001773): A measured foot length that is more than 2 SD below the mean for a newborn of 27 - 41 weeks gestation, or foot that is less than the 3rd centile for individuals from birth to 16 years of age (objective). Alternatively, a foot that appears disproportionately short (subjective). Evidence: TAS. Frequency: Very frequent (HP:0040281). (ORPHA:93388)
- Scoliosis (HP:0002650): The presence of an abnormal lateral curvature of the spine. Evidence: TAS. Frequency: Occasional (HP:0040283). (ORPHA:93388)
- Hypoplasia of the ulna (HP:0003022): Underdevelopment of the ulna. Evidence: TAS. Frequency: Occasional (HP:0040283). (ORPHA:93388)
- Clinodactyly of the 5th finger (HP:0004209): Clinodactyly refers to a bending or curvature of the fifth finger in the radial direction (i.e., towards the 4th finger). Evidence: TAS. Frequency: Occasional (HP:0040283). (ORPHA:93388)
- Short stature (HP:0004322): A height below that which is expected according to age and gender norms. Although there is no universally accepted definition of short stature, many refer to "short stature" as height more than 2 standard deviations below the mean for age and gender (or below the 3rd percentile for age and gender dependent norms). Evidence: TAS. Frequency: Very frequent (HP:0040281). (ORPHA:93388)
- Short middle phalanx of finger (HP:0005819): Short (hypoplastic) middle phalanx of finger, affecting one or more fingers. Evidence: TAS. Frequency: Very frequent (HP:0040281). (ORPHA:93388)
- Short thumb (HP:0009778): Hypoplasia (congenital reduction in size) of the thumb. Evidence: TAS. Frequency: Very frequent (HP:0040281). (ORPHA:93388)
- Short hallux (HP:0010109): Underdevelopment (hypoplasia) of the big toe. Evidence: TAS. Frequency: Very frequent (HP:0040281). (ORPHA:93388)
- Cone-shaped epiphysis (HP:0010579): Cone-shaped epiphyses (also known as coned epiphyses) are epiphyses that invaginate into cupped metaphyses. That is, the epiphysis has a cone-shaped distal extension resulting from increased growth of the central portion of the epiphysis relative to its periphery. Evidence: TAS. Frequency: Frequent (HP:0040282). (ORPHA:93388)
These phenotypes are associated with the disease Brachydactyly type A1 (ORPHA:93388).